- Paroxysmal sneezing (HP:0025096): Unprovoked explosive pathological sneezing. Evidence: PCS. (PMID:2275931)
- Autosomal dominant inheritance (HP:0000006): A mode of inheritance that is observed for traits related to a gene encoded on one of the autosomes (i.e., the human chromosomes 1-22) in which a trait manifests in heterozygotes. In the context of medical genetics, an autosomal dominant disorder is caused when a single copy of the mutant allele is present. Males and females are affected equally, and can both transmit the disorder with a risk of 50% for each child of inheriting the mutant allele. Evidence: IEA. (OMIM:100820)
These phenotypes are associated with the disease Achoo syndrome (OMIM:100820).